- Microcephaly (HP:0000252): Head circumference below 2 standard deviations below the mean for age and gender. Evidence: TAS. Frequency: Very frequent (HP:0040281). (ORPHA:404473)
- Intellectual disability (HP:0001249): The term intellectual disability or intellectual developmental disorder is used to describe significantly sub-average intellectual and adaptive functioning based on clinical assessment and as measured by individually administered, appropriately normed, standardized and validated tests of intellectual functioning and adaptive behavior, with onset during the developmental period from infancy through adolescence. Evidence: TAS. Frequency: Very frequent (HP:0040281). (ORPHA:404473)
- Spasticity (HP:0001257): A motor disorder characterized by a velocity-dependent increase in tonic stretch reflexes with increased muscle tone, exaggerated (hyperexcitable) tendon reflexes. Evidence: TAS. Frequency: Very frequent (HP:0040281). (ORPHA:404473)
- Motor delay (HP:0001270): A type of Developmental delay characterized by a delay in acquiring motor skills. Evidence: TAS. Frequency: Very frequent (HP:0040281). (ORPHA:404473)
- Abnormal facial shape (HP:0001999): An abnormal morphology (form) of the face or its components. Evidence: TAS. Frequency: Very frequent (HP:0040281). (ORPHA:404473)
- Poor speech (HP:0002465). Evidence: TAS. Frequency: Very frequent (HP:0040281). (ORPHA:404473)
- Axial hypotonia (HP:0008936): Muscular hypotonia (abnormally low muscle tone) affecting the musculature of the trunk. Evidence: TAS. Frequency: Very frequent (HP:0040281). (ORPHA:404473)
- Abnormality of the eye (HP:0000478): Any abnormality of the eye, including location, spacing, and intraocular abnormalities. Evidence: TAS. Frequency: Frequent (HP:0040282). (ORPHA:404473)
- Atypical behavior (HP:0000708): Atypical behavior is an abnormality in a person's actions that can be controlled or modulated by the will of the individual. While abnormal behaviors can be difficult to control, they are distinct from other abnormal actions that cannot be affected by the individual's will. Evidence: TAS. Frequency: Frequent (HP:0040282). (ORPHA:404473)
- Developmental regression (HP:0002376): Loss of developmental skills, as manifested by loss of developmental milestones. Evidence: TAS. Frequency: Frequent (HP:0040282). (ORPHA:404473)
- Primary microcephaly (HP:0011451): Head circumference below 2 standard deviations below the mean for age and gender at birth. Evidence: TAS. Frequency: Frequent (HP:0040282). (ORPHA:404473)
- Thin upper lip vermilion (HP:0000219): Height of the vermilion of the upper lip in the midline more than 2 SD below the mean. Alternatively, an apparently reduced height of the vermilion of the upper lip in the frontal view (subjective). Evidence: TAS. Frequency: Occasional (HP:0040283). (ORPHA:404473)
- Smooth philtrum (HP:0000319): Flat skin surface, with no ridge formation in the central region of the upper lip between the nasal base and upper vermilion border. Evidence: TAS. Frequency: Occasional (HP:0040283). (ORPHA:404473)
- Long philtrum (HP:0000343): Distance between nasal base and midline upper lip vermilion border more than 2 SD above the mean. Alternatively, an apparently increased distance between nasal base and midline upper lip vermilion border. Evidence: TAS. Frequency: Occasional (HP:0040283). (ORPHA:404473)
- Underdeveloped nasal alae (HP:0000430): Thinned, deficient, or excessively arched ala nasi. Evidence: TAS. Frequency: Occasional (HP:0040283). (ORPHA:404473)
- Broad nasal tip (HP:0000455): Increase in width of the nasal tip. Evidence: TAS. Frequency: Occasional (HP:0040283). (ORPHA:404473)
- Strabismus (HP:0000486): A misalignment of the eyes so that the visual axes deviate from bifoveal fixation. The classification of strabismus may be based on a number of features including the relative position of the eyes, whether the deviation is latent or manifest, intermittent or constant, concomitant or otherwise and according to the age of onset and the relevance of any associated refractive error. Evidence: TAS. Frequency: Occasional (HP:0040283). (ORPHA:404473)
- Hypermetropia (HP:0000540): An abnormality of refraction characterized by the ability to see objects in the distance clearly, while objects nearby appear blurry. Evidence: TAS. Frequency: Occasional (HP:0040283). (ORPHA:404473)
- Myopia (HP:0000545): An abnormality of refraction characterized by the ability to see objects nearby clearly, while objects in the distance appear blurry. Evidence: TAS. Frequency: Occasional (HP:0040283). (ORPHA:404473)
- Aggressive behavior (HP:0000718): Behavior or an act aimed at harming a person, animal, or physical property (e.g., acts of physical violence; shouting, swearing, and using harsh language; slashing someone's tires). Evidence: TAS. Frequency: Occasional (HP:0040283). (ORPHA:404473)
- Autistic behavior (HP:0000729): Persistent deficits in social interaction and communication and interaction as well as a markedly restricted repertoire of activity and interest as well as repetitive patterns of behavior. Evidence: TAS. Frequency: Occasional (HP:0040283). (ORPHA:404473)
- Hypoplasia of the corpus callosum (HP:0002079): Underdevelopment of the corpus callosum. Evidence: TAS. Frequency: Occasional (HP:0040283). (ORPHA:404473)
- Ventriculomegaly (HP:0002119): An increase in size of the ventricular system of the brain. Evidence: TAS. Frequency: Occasional (HP:0040283). (ORPHA:404473)
- Tethered cord (HP:0002144): During normal embryological development, the spinal cord first occupies the entire length of the vertebral column but goes on to assume a position at the level of L1 due to differential growth of the conus medullaris and the vertebral column. The filum terminale is a slender, threadlike structure that remains after the normal regression of the distal embryonic spinal cord and attaches the spinal cord to the coccyx. A tethered cord results if there is a thickened rope-like filum terminale which anchors the cord at the level of L2 or below, potentially causing neurologic signs owing to abnormal tension on the spinal cord. Evidence: TAS. Frequency: Occasional (HP:0040283). (ORPHA:404473)
- Delayed CNS myelination (HP:0002188): Delayed myelination in the central nervous system. Evidence: TAS. Frequency: Occasional (HP:0040283). (ORPHA:404473)
- Sleep disturbance (HP:0002360): An abnormal pattern in the quality, quantity, or characteristics of sleep. Evidence: TAS. Frequency: Occasional (HP:0040283). (ORPHA:404473)
- Syringomyelia (HP:0003396): Dilated, glial-lined cavity in spinal cord. This cavity does not communicate with the central canal, and usually is between the dorsal columns unilaterally or bilaterally along the side of the cord. Evidence: TAS. Frequency: Occasional (HP:0040283). (ORPHA:404473)
- Low hanging columella (HP:0009765): Columella extending inferior to the level of the nasal base, when viewed from the side. Evidence: TAS. Frequency: Occasional (HP:0040283). (ORPHA:404473)
- Abnormal temper tantrums (HP:0025160): Temper tantrums are brief episodes of extreme, unpleasant, and sometimes aggressive behaviors in response to frustration or anger, which are a normal part of development in toddlers. Temper tantrums that occur more frequently in a given time and/or are more severe in symptomatology and/or longer in duration and/or inappropriate for the given age compared to a temper tantrum that naturally occurs as a part of the developmental process are classified as abnormal temper tantrums. Evidence: TAS. Frequency: Occasional (HP:0040283). (ORPHA:404473)
- Self-injurious behavior (HP:0100716): Self-aggression. Evidence: TAS. Frequency: Occasional (HP:0040283). (ORPHA:404473)
- Hearing impairment (HP:0000365): A decreased magnitude of the sensory perception of sound. Evidence: TAS. Frequency: Very rare (HP:0040284). (ORPHA:404473)
- Seizure (HP:0001250): A seizure is an intermittent abnormality of nervous system physiology characterized by a transient occurrence of signs and/or symptoms due to abnormal excessive or synchronous neuronal activity in the brain. Evidence: TAS. Frequency: Very rare (HP:0040284). (ORPHA:404473)
These phenotypes are associated with the disease Intellectual disability-eye abnormalities-microcephaly-peripheral spasticity syndrome (ORPHA:404473).